- Sensorineural hearing impairment (HP:0000407): A type of hearing impairment in one or both ears related to an abnormal functionality of the cochlear nerve. Evidence: IEA. (OMIM:609646)
- Nonprogressive (HP:0003680): Applies to a disease manifestation that does not increase in scope or severity over the course of time, i.e., that does not worsen with age. Evidence: IEA. (OMIM:609646)
- Infantile onset (HP:0003593): Onset of signs or symptoms of disease between 28 days to one year of life. Evidence: IEA. (OMIM:609646)
- Autosomal recessive inheritance (HP:0000007): A mode of inheritance that is observed for traits related to a gene encoded on one of the autosomes (i.e., the human chromosomes 1-22) in which a trait manifests in individuals with two pathogenic alleles, either homozygotes (two copies of the same mutant allele) or compound heterozygotes (whereby each copy of a gene has a distinct mutant allele). Evidence: IEA. (OMIM:609646)
These phenotypes are associated with the disease autosomal recessive nonsyndromic hearing loss 42 (OMIM:609646).